Phenotypes associated with the disease DYRK1A-related intellectual disability syndrome (ORPHA:464306):
- Microcephaly (HP:0000252): Head circumference below 2 standard deviations below the mean for age and gender. Evidence: TAS. Frequency: Very frequent (HP:0040281). (ORPHA:464306)
- Delayed speech and language development (HP:0000750): A degree of language development that is significantly below the norm for a child of a specified age. Evidence: TAS. Frequency: Very frequent (HP:0040281). (ORPHA:464306)
- Intellectual disability (HP:0001249): The term intellectual disability or intellectual developmental disorder is used to describe significantly sub-average intellectual and adaptive functioning based on clinical assessment and as measured by individually administered, appropriately normed, standardized and validated tests of intellectual functioning and adaptive behavior, with onset during the developmental period from infancy through adolescence. Evidence: TAS. Frequency: Very frequent (HP:0040281). (ORPHA:464306)
- Global developmental delay (HP:0001263): A delay in the achievement of motor or mental milestones in the domains of development of a child, including motor skills, speech and language, cognitive skills, and social and emotional skills. This term should only be used to describe children younger than five years of age. Evidence: TAS. Frequency: Very frequent (HP:0040281). (ORPHA:464306)
- Gait disturbance (HP:0001288): The term gait disturbance can refer to any disruption of the ability to walk. Evidence: TAS. Frequency: Very frequent (HP:0040281). (ORPHA:464306)
- Abnormal facial shape (HP:0001999): An abnormal morphology (form) of the face or its components. Evidence: TAS. Frequency: Very frequent (HP:0040281). (ORPHA:464306)
- Acromesomelia (HP:0003086): Small hands and feet. Evidence: TAS. Frequency: Very frequent (HP:0040281). (ORPHA:464306)
- Feeding difficulties (HP:0011968): Impaired ability to eat related to problems gathering food and getting ready to suck, chew, or swallow it. Evidence: TAS. Frequency: Very frequent (HP:0040281). (ORPHA:464306)
- Visual impairment (HP:0000505): Visual impairment (or vision impairment) is vision loss (of a person) to such a degree as to qualify as an additional support need through a significant limitation of visual capability resulting from either disease, trauma, or congenital or degenerative conditions that cannot be corrected by conventional means, such as refractive correction, medication, or surgery. Evidence: TAS. Frequency: Frequent (HP:0040282). (ORPHA:464306)
- Atypical behavior (HP:0000708): Atypical behavior is an abnormality in a person's actions that can be controlled or modulated by the will of the individual. While abnormal behaviors can be difficult to control, they are distinct from other abnormal actions that cannot be affected by the individual's will. Evidence: TAS. Frequency: Frequent (HP:0040282). (ORPHA:464306)
- Autistic behavior (HP:0000729): Persistent deficits in social interaction and communication and interaction as well as a markedly restricted repertoire of activity and interest as well as repetitive patterns of behavior. Evidence: TAS. Frequency: Frequent (HP:0040282). (ORPHA:464306)
- Motor stereotypy (HP:0000733): Use of the same abnormal action in response to certain triggers or at random. They may be used as a way to regulate one's internal state but must otherwise have no apparent functional purpose. Evidence: TAS. Frequency: Frequent (HP:0040282). (ORPHA:464306)
- Anxiety (HP:0000739): Intense feelings of nervousness, tension, or panic often arise in response to interpersonal stresses. There is worry about the negative effects of past unpleasant experiences and future negative possibilities. Individuals may feel fearful, apprehensive, or threatened by uncertainty, and they may also have fears of falling apart or losing control. Evidence: TAS. Frequency: Frequent (HP:0040282). (ORPHA:464306)
- Seizure (HP:0001250): A seizure is an intermittent abnormality of nervous system physiology characterized by a transient occurrence of signs and/or symptoms due to abnormal excessive or synchronous neuronal activity in the brain. Evidence: TAS. Frequency: Frequent (HP:0040282). (ORPHA:464306)
- Failure to thrive (HP:0001508): Failure to thrive (FTT) refers to a child whose physical growth is substantially below the norm. Evidence: TAS. Frequency: Frequent (HP:0040282). (ORPHA:464306)
- Intrauterine growth retardation (HP:0001511): An abnormal restriction of fetal growth with fetal weight below the tenth percentile for gestational age. Evidence: TAS. Frequency: Frequent (HP:0040282). (ORPHA:464306)
- Small for gestational age (HP:0001518): Smaller than normal size according to sex and gestational age related norms, defined as a weight below the 10th percentile for the gestational age. Evidence: TAS. Frequency: Frequent (HP:0040282). (ORPHA:464306)
- Ventriculomegaly (HP:0002119): An increase in size of the ventricular system of the brain. Evidence: TAS. Frequency: Frequent (HP:0040282). (ORPHA:464306)
- Febrile seizure (within the age range of 3 months to 6 years) (HP:0002373): A febrile seizure is any type of seizure (most often a generalized tonic-clonic seizure) occurring with fever (at least 38 degrees Celsius) but in the absence of central nervous system infection, severe metabolic disturbance or other alternative precipitant in children between the ages of 3 months and 6 years. Evidence: TAS. Frequency: Frequent (HP:0040282). (ORPHA:464306)
- Poor speech (HP:0002465). Evidence: TAS. Frequency: Frequent (HP:0040282). (ORPHA:464306)
- Primary microcephaly (HP:0011451): Head circumference below 2 standard deviations below the mean for age and gender at birth. Evidence: TAS. Frequency: Frequent (HP:0040282). (ORPHA:464306)
- Cryptorchidism (HP:0000028): Testis in inguinal canal. That is, absence of one or both testes from the scrotum owing to failure of the testis or testes to descend through the inguinal canal to the scrotum. Evidence: TAS. Frequency: Occasional (HP:0040283). (ORPHA:464306)
- Narrow forehead (HP:0000341): Width of the forehead or distance between the frontotemporales is more than two standard deviations below the mean (objective); or apparently narrow intertemporal region (subjective). Evidence: TAS. Frequency: Occasional (HP:0040283). (ORPHA:464306)
- Macrotia (HP:0000400): Median longitudinal ear length greater than two standard deviations above the mean and median ear width greater than two standard deviations above the mean (objective); or, apparent increase in length and width of the pinna (subjective). Evidence: TAS. Frequency: Occasional (HP:0040283). (ORPHA:464306)
- Protruding ear (HP:0000411): Angle formed by the plane of the ear and the mastoid bone greater than the 97th centile for age (objective); or, outer edge of the helix more than 2 cm from the mastoid at the point of maximum distance (objective). Evidence: TAS. Frequency: Occasional (HP:0040283). (ORPHA:464306)
- Prominent nasal bridge (HP:0000426): Anterior positioning of the nasal root in comparison to the usual positioning for age. Evidence: TAS. Frequency: Occasional (HP:0040283). (ORPHA:464306)
- Astigmatism (HP:0000483): A type of refraction error associated with abnormal curvatures on the anterior and/or posterior surface of the cornea. Evidence: TAS. Frequency: Occasional (HP:0040283). (ORPHA:464306)
- Strabismus (HP:0000486): A misalignment of the eyes so that the visual axes deviate from bifoveal fixation. The classification of strabismus may be based on a number of features including the relative position of the eyes, whether the deviation is latent or manifest, intermittent or constant, concomitant or otherwise and according to the age of onset and the relevance of any associated refractive error. Evidence: TAS. Frequency: Occasional (HP:0040283). (ORPHA:464306)
- Deeply set eye (HP:0000490): An eye that is more deeply recessed into the plane of the face than is typical. Evidence: TAS. Frequency: Occasional (HP:0040283). (ORPHA:464306)
- Hypermetropia (HP:0000540): An abnormality of refraction characterized by the ability to see objects in the distance clearly, while objects nearby appear blurry. Evidence: TAS. Frequency: Occasional (HP:0040283). (ORPHA:464306)
- Optic disc pallor (HP:0000543): A pale yellow discoloration of the optic disc (the area of the optic nerve head in the retina). The optic disc normally has a pinkish hue with a central yellowish depression. Evidence: TAS. Frequency: Occasional (HP:0040283). (ORPHA:464306)
- Myopia (HP:0000545): An abnormality of refraction characterized by the ability to see objects nearby clearly, while objects in the distance appear blurry. Evidence: TAS. Frequency: Occasional (HP:0040283). (ORPHA:464306)
- Exotropia (HP:0000577): A form of strabismus with one or both eyes deviated outward. Evidence: TAS. Frequency: Occasional (HP:0040283). (ORPHA:464306)
- Amblyopia (HP:0000646): Reduced visual acuity that is uncorrectable by lenses in the absence of detectable anatomic defects in the eye or visual pathways. Evidence: TAS. Frequency: Occasional (HP:0040283). (ORPHA:464306)
- Hyperactivity (HP:0000752): Hyperactivity is a condition characterized by constant and unusually high levels of activity, even in situations where it is deemed inappropriate. Evidence: TAS. Frequency: Occasional (HP:0040283). (ORPHA:464306)
- Arachnodactyly (HP:0001166): Abnormally long and slender fingers (spider fingers). Evidence: TAS. Frequency: Occasional (HP:0040283). (ORPHA:464306)
- Aortic regurgitation (HP:0001659): An insufficiency of the aortic valve, leading to regurgitation (backward flow) of blood from the aorta into the left ventricle. Evidence: TAS. Frequency: Occasional (HP:0040283). (ORPHA:464306)
- Toe syndactyly (HP:0001770): Webbing or fusion of the toes, involving soft parts only or including bone structure. Bony fusions are referred to as "bony" Syndactyly if the fusion occurs in a radio-ulnar axis. Fusions of bones of the toes in a proximo-distal axis are referred to as "Symphalangism". Evidence: TAS. Frequency: Occasional (HP:0040283). (ORPHA:464306)
- Vomiting (HP:0002013): Forceful ejection of the contents of the stomach through the mouth by means of a series of involuntary spasmic contractions. Evidence: TAS. Frequency: Occasional (HP:0040283). (ORPHA:464306)
- Gastroesophageal reflux (HP:0002020): A condition in which the stomach contents leak backwards from the stomach into the esophagus through the lower esophageal sphincter. Evidence: TAS. Frequency: Occasional (HP:0040283). (ORPHA:464306)
- Hypoplasia of the corpus callosum (HP:0002079): Underdevelopment of the corpus callosum. Evidence: TAS. Frequency: Occasional (HP:0040283). (ORPHA:464306)
- Cerebral cortical atrophy (HP:0002120): Atrophy of the cortex of the cerebrum. Evidence: TAS. Frequency: Occasional (HP:0040283). (ORPHA:464306)
- Hypoplasia of the brainstem (HP:0002365): Underdevelopment of the brainstem. Evidence: TAS. Frequency: Occasional (HP:0040283). (ORPHA:464306)
- Recurrent infections (HP:0002719): Increased susceptibility to infections as manifested by repeated bouts of infection. Evidence: TAS. Frequency: Occasional (HP:0040283). (ORPHA:464306)
- Multiple joint contractures (HP:0002828). Evidence: TAS. Frequency: Occasional (HP:0040283). (ORPHA:464306)
- Clinodactyly of the 5th finger (HP:0004209): Clinodactyly refers to a bending or curvature of the fifth finger in the radial direction (i.e., towards the 4th finger). Evidence: TAS. Frequency: Occasional (HP:0040283). (ORPHA:464306)
- Corneal opacity (HP:0007957): A reduction of corneal clarity. Evidence: TAS. Frequency: Occasional (HP:0040283). (ORPHA:464306)
- Polydactyly (HP:0010442): A congenital anomaly characterized by the presence of supernumerary fingers or toes. Evidence: TAS. Frequency: Occasional (HP:0040283). (ORPHA:464306)
- Anterior pituitary hypoplasia (HP:0010627): Underdevelopment of the anterior pituitary gland. Evidence: TAS. Frequency: Occasional (HP:0040283). (ORPHA:464306)
- Severe intellectual disability (HP:0010864): Severe intellectual disability (ID) is defined as a type of ID characterized by severely sub-average adaptive functioning and intellectual functioning, with an intelligence quotient (IQ) the range of 20-34. Evidence: TAS. Frequency: Occasional (HP:0040283). (ORPHA:464306)
- Narrow nasal tip (HP:0011832): Decrease in width of the nasal tip. Evidence: TAS. Frequency: Occasional (HP:0040283). (ORPHA:464306)
- Hypospadias (HP:0000047): Abnormal position of urethral meatus on the ventral penile shaft (underside) characterized by displacement of the urethral meatus from the tip of the glans penis to the ventral surface of the penis, scrotum, or perineum. Evidence: TAS. Frequency: Very rare (HP:0040284). (ORPHA:464306)
- Micropenis (HP:0000054): Abnormally small penis. At birth, the normal penis is about 3 cm (stretched length from pubic tubercle to tip of penis) with micropenis less than 2.0-2.5 cm. Evidence: TAS. Frequency: Very rare (HP:0040284). (ORPHA:464306)
- Renal cyst (HP:0000107): A fluid filled sac in the kidney. Evidence: TAS. Frequency: Very rare (HP:0040284). (ORPHA:464306)
- Unilateral renal agenesis (HP:0000122): A unilateral form of agenesis of the kidney. Evidence: TAS. Frequency: Very rare (HP:0040284). (ORPHA:464306)
- Pelvic kidney (HP:0000125): A developmental defect in which a kidney is located in an abnormal anatomic position within the pelvis. Evidence: TAS. Frequency: Very rare (HP:0040284). (ORPHA:464306)
- Hydronephrosis (HP:0000126): Severe distention of the kidney with dilation of the renal pelvis and calices. Evidence: TAS. Frequency: Very rare (HP:0040284). (ORPHA:464306)
- Pectus excavatum (HP:0000767): A defect of the chest wall characterized by a depression of the sternum, giving the chest ("pectus") a caved-in ("excavatum") appearance. Evidence: TAS. Frequency: Very rare (HP:0040284). (ORPHA:464306)
- Eczematoid dermatitis (HP:0000964): Eczema is a form of dermatitis that is characterized by scaly, pruritic, erythematous lesions located on flexural surfaces. Evidence: TAS. Frequency: Very rare (HP:0040284). (ORPHA:464306)
- Oligohydramnios (HP:0001562): Diminished amniotic fluid volume in pregnancy. Evidence: TAS. Frequency: Very rare (HP:0040284). (ORPHA:464306)
- Ventricular septal defect (HP:0001629): A hole between the two bottom chambers (ventricles) of the heart. The defect is centered around the most superior aspect of the ventricular septum. Evidence: TAS. Frequency: Very rare (HP:0040284). (ORPHA:464306)
- Patent ductus arteriosus (HP:0001643): In utero, the ductus arteriosus (DA) serves to divert ventricular output away from the lungs and toward the placenta by connecting the main pulmonary artery to the descending aorta. A patent ductus arteriosus (PDA) in the first 3 days of life is a physiologic shunt in healthy term and preterm newborn infants, and normally is substantially closed within about 24 hours after bith and completely closed after about three weeks. Failure of physiologcal closure is referred to a persistent or patent ductus arteriosus (PDA). Depending on the degree of left-to-right shunting, PDA can have clinical consequences. Evidence: TAS. Frequency: Very rare (HP:0040284). (ORPHA:464306)
- Aortic valve stenosis (HP:0001650): The presence of a stenosis (narrowing) of the aortic valve. Evidence: TAS. Frequency: Very rare (HP:0040284). (ORPHA:464306)
- Hallux valgus (HP:0001822): Lateral deviation of the great toe (i.e., in the direction of the little toe). Evidence: TAS. Frequency: Very rare (HP:0040284). (ORPHA:464306)
- Pyloric stenosis (HP:0002021): Pyloric stenosis, also known as infantile hypertrophic pyloric stenosis, is an uncommon condition in infants characterized by abnormal thickening of the pylorus muscles in the stomach leading to gastric outlet obstruction. Clinically infants are well at birth. Then, at 3 to 6 weeks of age, the infants present with projectile vomiting, potentially leading to dehydration and weight loss. Evidence: TAS. Frequency: Very rare (HP:0040284). (ORPHA:464306)
- Duodenal atresia (HP:0002247): A developmental defect resulting in complete obliteration of the duodenal lumen, that is, an abnormal closure of the duodenum. Evidence: TAS. Frequency: Very rare (HP:0040284). (ORPHA:464306)
- Enlarged cisterna magna (HP:0002280): Increase in size of the cisterna magna, one of three principal openings in the subarachnoid space between the arachnoid and pia mater, located between the cerebellum and the dorsal surface of the medulla oblongata. Evidence: TAS. Frequency: Very rare (HP:0040284). (ORPHA:464306)
- Scoliosis (HP:0002650): The presence of an abnormal lateral curvature of the spine. Evidence: TAS. Frequency: Very rare (HP:0040284). (ORPHA:464306)
- Kyphosis (HP:0002808): Exaggerated anterior convexity of the thoracic vertebral column. Evidence: TAS. Frequency: Very rare (HP:0040284). (ORPHA:464306)
- Breast hypoplasia (HP:0003187): Underdevelopment of the breast. Evidence: TAS. Frequency: Very rare (HP:0040284). (ORPHA:464306)
- Abnormality of the cervical spine (HP:0003319): Any abnormality of the cervical vertebral column. Evidence: TAS. Frequency: Very rare (HP:0040284). (ORPHA:464306)
- Short stature (HP:0004322): A height below that which is expected according to age and gender norms. Although there is no universally accepted definition of short stature, many refer to "short stature" as height more than 2 standard deviations below the mean for age and gender (or below the 3rd percentile for age and gender dependent norms). Evidence: TAS. Frequency: Very rare (HP:0040284). (ORPHA:464306)
- Structural foot deformity (HP:0010219): A foot deformity resulting due to an abnormality affecting the bones of the foot (as well as muscle and soft tissue). In contrast if only the muscle and soft tissue are affected the term positional foot deformity applies. Evidence: TAS. Frequency: Very rare (HP:0040284). (ORPHA:464306)